Phenotypes associated with the disease D-glyceric aciduria (ORPHA:941):
- Loss of consciousness (HP:0007185): Loss of awareness of oneself or one's surroundings, involving (i) a loss of normal motor control is evident as flaccidity or stiffness, either of which can be accompanied by jerking movements, and postural control is lost so that patients fall if they are in an upright position; (ii) normal responsiveness is lost; and (iii) the patient experiences amnesia for the event. Loss of consciousness my be transitory (e.g., syncope) or prolonged. Evidence: TAS. Frequency: Occasional (HP:0040283). (ORPHA:941)
- Nonketotic hyperglycinemia (HP:0008288). Evidence: TAS. Frequency: Occasional (HP:0040283). (ORPHA:941)
- Severe global developmental delay (HP:0011344): A severe delay in the achievement of motor or mental milestones in the domains of development of a child. Evidence: TAS. Frequency: Occasional (HP:0040283). (ORPHA:941)
- Brain atrophy (HP:0012444): Partial or complete wasting (loss) of brain tissue that was once present. Evidence: TAS. Frequency: Occasional (HP:0040283). (ORPHA:941)
- Profound global developmental delay (HP:0012736): A profound delay in the achievement of motor or mental milestones in the domains of development of a child. Evidence: TAS. Frequency: Occasional (HP:0040283). (ORPHA:941)
- Cerebral visual impairment (HP:0100704): A form of loss of vision caused by damage to the visual cortex rather than a defect in the eye. Evidence: TAS. Frequency: Occasional (HP:0040283). (ORPHA:941)
- Metabolic acidosis (HP:0001942): Metabolic acidosis (MA) is characterized by a fall in blood pH due to a reduction of serum bicarbonate concentration. This can occur as a result of either the accumulation of acids (high anion gap MA) or the loss of bicarbonate from the gastrointestinal tract or the kidney (hyperchloremic MA). By definition, MA is not due to a respirary cause. Evidence: TAS. Frequency: Very frequent (HP:0040281). (ORPHA:941)
- Progressive encephalopathy (HP:0002448). Evidence: TAS. Frequency: Very frequent (HP:0040281). (ORPHA:941)
- Abnormal circulating enzyme concentration or activity (HP:0012379): Concentration or activity of an enzyme is above or below the limits of normal in the blood circulation. Evidence: TAS. Frequency: Very frequent (HP:0040281). (ORPHA:941)
- Microcephaly (HP:0000252): Head circumference below 2 standard deviations below the mean for age and gender. Evidence: TAS. Frequency: Frequent (HP:0040282). (ORPHA:941)
- Delayed speech and language development (HP:0000750): A degree of language development that is significantly below the norm for a child of a specified age. Evidence: TAS. Frequency: Frequent (HP:0040282). (ORPHA:941)
- Intellectual disability (HP:0001249): The term intellectual disability or intellectual developmental disorder is used to describe significantly sub-average intellectual and adaptive functioning based on clinical assessment and as measured by individually administered, appropriately normed, standardized and validated tests of intellectual functioning and adaptive behavior, with onset during the developmental period from infancy through adolescence. Evidence: TAS. Frequency: Frequent (HP:0040282). (ORPHA:941)
- Seizure (HP:0001250): A seizure is an intermittent abnormality of nervous system physiology characterized by a transient occurrence of signs and/or symptoms due to abnormal excessive or synchronous neuronal activity in the brain. Evidence: TAS. Frequency: Frequent (HP:0040282). (ORPHA:941)
- Spasticity (HP:0001257): A motor disorder characterized by a velocity-dependent increase in tonic stretch reflexes with increased muscle tone, exaggerated (hyperexcitable) tendon reflexes. Evidence: TAS. Frequency: Frequent (HP:0040282). (ORPHA:941)
- Global developmental delay (HP:0001263): A delay in the achievement of motor or mental milestones in the domains of development of a child, including motor skills, speech and language, cognitive skills, and social and emotional skills. This term should only be used to describe children younger than five years of age. Evidence: TAS. Frequency: Frequent (HP:0040282). (ORPHA:941)
- Hyperglycinemia (HP:0002154): An elevated concentration of glycine in the blood. Evidence: TAS. Frequency: Frequent (HP:0040282). (ORPHA:941)
- Hyperglycinuria (HP:0003108): An increased concentration of glycine in the urine. Evidence: TAS. Frequency: Frequent (HP:0040282). (ORPHA:941)
- Floppy infant (HP:0008947): Floppiness/hypotonia is defined as reduced resistance to passive movement of joints. Physical examination of floppy/hypotonic infants shows head lag, lack of shoulder and elbow muscle contraction on traction response, inability to tighten the shoulder girdle muscles (or slipping through) when held under the axillae, scarf sign (when the arm is pulled to the opposite side, the arm wraps around the neck with the elbow crossing midline), hyperdorsiflexion of the feet, easy apposition of the thumb against the forearm, feet touching the cheek with ease and without discomfort, frog leg position, and inverted U sign on ventral suspension (head, arms, and legs hanging down without elbow or knee flexion and the trunk rounded in a dome shape). Evidence: TAS. Frequency: Frequent (HP:0040282). (ORPHA:941)
- Increased circulating free fatty acid level (HP:0030781): A higher than normal levels of the fatty acids which can occur in plasma as a result of lipolysis in adipose tissue or when plasma triacyglycerols are taken into tissues. Evidence: TAS. Frequency: Frequent (HP:0040282). (ORPHA:941)
- Increased CSF glycine concentration (HP:0500230): Abnormally increased levels of glycine in cerebrospinal fluid. Evidence: TAS. Frequency: Frequent (HP:0040282). (ORPHA:941)
- Progressive microcephaly (HP:0000253): Progressive microcephaly is diagnosed when the head circumference falls progressively behind age- and gender-dependent norms. Evidence: TAS. Frequency: Occasional (HP:0040283). (ORPHA:941)
- Hearing impairment (HP:0000365): A decreased magnitude of the sensory perception of sound. Evidence: TAS. Frequency: Occasional (HP:0040283). (ORPHA:941)
- Autistic behavior (HP:0000729): Persistent deficits in social interaction and communication and interaction as well as a markedly restricted repertoire of activity and interest as well as repetitive patterns of behavior. Evidence: TAS. Frequency: Occasional (HP:0040283). (ORPHA:941)
- Myoclonus (HP:0001336): Very brief, involuntary random muscular contractions occurring at rest, in response to sensory stimuli, or accompanying voluntary movements. Evidence: TAS. Frequency: Occasional (HP:0040283). (ORPHA:941)
- Chorea (HP:0002072): Chorea (Greek for 'dance') refers to widespread arrhythmic involuntary movements of a forcible, jerky and restless fashion. It is a random-appearing sequence of one or more discrete involuntary movements or movement fragments. Movements appear random because of variability in timing, duration or location. Each movement may have a distinct start and end. However, movements may be strung together and thus may appear to flow randomly from one muscle group to another. Chorea can involve the trunk, neck, face, tongue, and extremities. Evidence: TAS. Frequency: Occasional (HP:0040283). (ORPHA:941)
- Hypoplasia of the corpus callosum (HP:0002079): Underdevelopment of the corpus callosum. Evidence: TAS. Frequency: Occasional (HP:0040283). (ORPHA:941)